- Hyperpigmentation of the skin (HP:0000953): A darkening of the skin related to an increase in melanin production and deposition. Evidence: TAS. (OMIM:145200)
- Autosomal dominant inheritance (HP:0000006): A mode of inheritance that is observed for traits related to a gene encoded on one of the autosomes (i.e., the human chromosomes 1-22) in which a trait manifests in heterozygotes. In the context of medical genetics, an autosomal dominant disorder is caused when a single copy of the mutant allele is present. Males and females are affected equally, and can both transmit the disorder with a risk of 50% for each child of inheriting the mutant allele. Evidence: IEA. (OMIM:145200)
These phenotypes are associated with the disease hyperpigmentation of Fuldauer and Kuijpers (OMIM:145200).